- Neoplasm of the central nervous system (HP:0100006): A neoplasm of the central nervous system. Evidence: IEA. (OMIM:603688)
- Prostate cancer (HP:0012125): A cancer of the prostate. Evidence: IEA. (OMIM:603688)
These phenotypes are associated with the disease prostate cancer/brain cancer susceptibility (OMIM:603688).